Phenotypes associated with the disease intellectual disability, X-linked 99 (OMIM:300919):
- Joint hypermobility (HP:0001382): The capability that a joint (or a group of joints) has to move, passively and/or actively, beyond normal limits along physiological axes. Evidence: PCS. Frequency: 1/5. (PMID:24607389)
- Global developmental delay (HP:0001263): A delay in the achievement of motor or mental milestones in the domains of development of a child, including motor skills, speech and language, cognitive skills, and social and emotional skills. This term should only be used to describe children younger than five years of age. Evidence: PCS. (PMID:24607389)
- Hypotonia (HP:0001252): Hypotonia is an abnormally low muscle tone (the amount of tension or resistance to movement in a muscle). Even when relaxed, muscles have a continuous and passive partial contraction which provides some resistance to passive stretching. Hypotonia thus manifests as diminished resistance to passive stretching. Hypotonia is not the same as muscle weakness, although the two conditions can co-exist. Evidence: PCS. Frequency: 5/5. (PMID:24607389)
- Ectopic kidney (HP:0000086): A developmental defect in which a kidney is located in an abnormal anatomic position. Evidence: PCS. Frequency: 1/5. (PMID:24607389)
- Gastroesophageal reflux (HP:0002020): A condition in which the stomach contents leak backwards from the stomach into the esophagus through the lower esophageal sphincter. Evidence: PCS. Frequency: 1/5. (PMID:24607389)
- Relative macrocephaly (HP:0004482): A relatively mild degree of macrocephaly in which the head circumference is not above two standard deviations from the mean, but appears dysproportionately large when other factors such as body stature are taken into account. Evidence: PCS. Frequency: 1/5. (PMID:24607389)
- Broad thumb (HP:0011304): Increased thumb width without increased dorso-ventral dimension. Evidence: PCS. Frequency: 2/5. (PMID:24607389)
- X-linked recessive inheritance (HP:0001419): A mode of inheritance that is observed for recessive traits related to a gene encoded on the X chromosome. In the context of medical genetics, X-linked recessive disorders manifest in males (who have one copy of the X chromosome and are thus hemizygotes), but generally not in female heterozygotes who have one mutant and one normal allele. Evidence: PCS. (PMID:24607389)
- Broad hallux (HP:0010055): Visible increase in width of the hallux without an increase in the dorso-ventral dimension. Evidence: PCS. Frequency: 1/5. (PMID:24607389)
- Prominent forehead (HP:0011220): Forward prominence of the entire forehead, due to protrusion of the frontal bone. Evidence: PCS. Frequency: 1/5. (PMID:24607389)
- Aggressive behavior (HP:0000718): Behavior or an act aimed at harming a person, animal, or physical property (e.g., acts of physical violence; shouting, swearing, and using harsh language; slashing someone's tires). Evidence: PCS. Frequency: 1/5. (PMID:24607389)
- Autistic behavior (HP:0000729): Persistent deficits in social interaction and communication and interaction as well as a markedly restricted repertoire of activity and interest as well as repetitive patterns of behavior. Evidence: PCS. Frequency: 1/5. (PMID:24607389)
- Chronic constipation (HP:0012450): Constipation for longer than three months with fewer than 3 bowel movements per week, straining, lumpy or hard stools, and a sensation of anorectal obstruction or incomplete defecation. Evidence: PCS. Frequency: 1/5. (PMID:24607389)
- Compulsive behaviors (HP:0000722): Behavior that consists of repetitive acts, characterized by the feeling that one "has to" perform them, while being aware that these acts are not in line with one's overall goal. Evidence: PCS. Frequency: 1/5. (PMID:24607389)
- Tracheomalacia (HP:0002779). Evidence: PCS. Frequency: 1/5. (PMID:24607389)
- Intrauterine growth retardation (HP:0001511): An abnormal restriction of fetal growth with fetal weight below the tenth percentile for gestational age. Evidence: PCS. Frequency: 1/5. Onset: Fetal onset (HP:0011461). (PMID:24607389)
- Hypospadias (HP:0000047): Abnormal position of urethral meatus on the ventral penile shaft (underside) characterized by displacement of the urethral meatus from the tip of the glans penis to the ventral surface of the penis, scrotum, or perineum. Evidence: PCS. Frequency: 1/5. (PMID:24607389)
- Intellectual disability (HP:0001249): The term intellectual disability or intellectual developmental disorder is used to describe significantly sub-average intellectual and adaptive functioning based on clinical assessment and as measured by individually administered, appropriately normed, standardized and validated tests of intellectual functioning and adaptive behavior, with onset during the developmental period from infancy through adolescence. Evidence: PCS. Frequency: 5/5. (PMID:24607389)